- Angioedema (HP:0100665): Rapid swelling (edema) of the dermis, subcutaneous tissue, mucosa and submucosal tissues of the skin of the face, normally around the mouth, and the mucosa of the mouth and/or throat, as well as the tongue during a period of minutes to several hours. The swelling can also occur elsewhere, typically in the hands. Angioedema is similar to urticaria, but the swelling is subcutaneous rather than on the epidermis. Evidence: PCS. Frequency: 4/4. Onset: Juvenile onset (HP:0003621). (PMID:28601681)
- Nailfold capillary tortuosity (HP:0033250): An increased number of turns of the blood vessels of the nailfold with a charactereistic winded or twisted appearance of the blood vessels. Evidence: PCS. (PMID:28601681)
- Facial edema (HP:0000282). Evidence: PCS. (PMID:28601681)
- Nail bed hemorrhage (HP:0030254): Small areas of bleeding (hemorrhage) under the fingernail or toenail. Evidence: PCS. (PMID:28601681)
- Swollen lip (HP:0031244): Enlargement of the lip typically due to fluid buildup or inflammation. Evidence: PCS. (PMID:28601681)
- Autosomal dominant inheritance (HP:0000006): A mode of inheritance that is observed for traits related to a gene encoded on one of the autosomes (i.e., the human chromosomes 1-22) in which a trait manifests in heterozygotes. In the context of medical genetics, an autosomal dominant disorder is caused when a single copy of the mutant allele is present. Males and females are affected equally, and can both transmit the disorder with a risk of 50% for each child of inheriting the mutant allele. Evidence: PCS. (PMID:28601681)
- Edema of the dorsum of hands (HP:0007514): An abnormal accumulation of fluid beneath the skin on the back of the hands. Evidence: PCS. (PMID:28601681)
These phenotypes are associated with the disease angioedema, hereditary, 5 (OMIM:619361).